- Everted lower lip vermilion (HP:0000232): An abnormal configuration of the lower lip such that it is turned outward i.e., everted, with the Inner aspect of the lower lip vermilion (normally opposing the teeth) being visible in a frontal view. Evidence: TAS. Frequency: Frequent (HP:0040282). (ORPHA:2964)
- Mandibular prognathia (HP:0000303): Abnormal prominence of the chin related to increased length of the mandible. Evidence: TAS. Frequency: Very frequent (HP:0040281). (ORPHA:2964)
- Open bite (HP:0010807): Visible space between the dental arches in occlusion. Evidence: TAS. Frequency: Very frequent (HP:0040281). (ORPHA:2964)
These phenotypes are associated with the disease Autosomal dominant prognathism (ORPHA:2964).